- Postaxial hand polydactyly (HP:0001162): Supernumerary digits located at the ulnar side of the hand (that is, on the side with the fifth finger). Evidence: IEA. (OMIM:263450)
- Autosomal recessive inheritance (HP:0000007): A mode of inheritance that is observed for traits related to a gene encoded on one of the autosomes (i.e., the human chromosomes 1-22) in which a trait manifests in individuals with two pathogenic alleles, either homozygotes (two copies of the same mutant allele) or compound heterozygotes (whereby each copy of a gene has a distinct mutant allele). Evidence: IEA. (OMIM:263450)
- Cutaneous finger syndactyly (HP:0010554): A soft tissue continuity in the A/P axis between two fingers that extends distally to at least the level of the proximal interphalangeal joints, or a soft tissue continuity in the A/P axis between two fingers that lies significantly distal to the flexion crease that overlies the metacarpophalangeal joint of the adjacent fingers. Evidence: TAS. Frequency: Occasional (HP:0040283). (OMIM:263450)
- Syndactyly (HP:0001159): Webbing or fusion of the fingers or toes, involving soft parts only or including bone structure. Bony fusions are referred to as "bony" syndactyly if the fusion occurs in a radio-ulnar axis. Fusions of bones of the fingers or toes in a proximo-distal axis are referred to as "symphalangism". Evidence: IEA. (OMIM:263450)
- Metacarpal synostosis (HP:0009701): Fusion involving two or more metacarpal bones (A synostosis of the first metacarpal and the proximal phalanx of the thumb can also be observed, note that the first metacarpal bone corresponds to a proximal phalanx). Evidence: IEA. (OMIM:263450)
These phenotypes are associated with the disease polydactyly, postaxial, type A5 (OMIM:263450).